- Abnormality of the immune system (HP:0002715): An abnormality of the immune system. Evidence: IEA. (OMIM:246300)
- Autosomal dominant inheritance (HP:0000006): A mode of inheritance that is observed for traits related to a gene encoded on one of the autosomes (i.e., the human chromosomes 1-22) in which a trait manifests in heterozygotes. In the context of medical genetics, an autosomal dominant disorder is caused when a single copy of the mutant allele is present. Males and females are affected equally, and can both transmit the disorder with a risk of 50% for each child of inheriting the mutant allele. Evidence: TAS. (OMIM:246300)
These phenotypes are associated with the disease leprosy, susceptibility to, 3 (OMIM:246300).